- Abnormality of the skeletal system (HP:0000924): An abnormality of the skeletal system. Evidence: IEA. (OMIM:273600)
- Peripheral neuropathy (HP:0009830): Peripheral neuropathy is a general term for any disorder of the peripheral nervous system. The main clinical features used to classify peripheral neuropathy are distribution, type (mainly demyelinating versus mainly axonal), duration, and course. Evidence: IEA. (OMIM:273600)
These phenotypes are associated with the disease THALIDOMIDE SUSCEPTIBILITY (OMIM:273600).